Phenotypes associated with the disease Gastrocutaneous syndrome (ORPHA:2069):
- Hypertelorism (HP:0000316): Interpupillary distance more than 2 SD above the mean (alternatively, the appearance of an increased interpupillary distance or widely spaced eyes). Evidence: TAS. Frequency: Very frequent (HP:0040281). (ORPHA:2069)
- Strabismus (HP:0000486): A misalignment of the eyes so that the visual axes deviate from bifoveal fixation. The classification of strabismus may be based on a number of features including the relative position of the eyes, whether the deviation is latent or manifest, intermittent or constant, concomitant or otherwise and according to the age of onset and the relevance of any associated refractive error. Evidence: TAS. Frequency: Occasional (HP:0040283). (ORPHA:2069)
- Myopia (HP:0000545): An abnormality of refraction characterized by the ability to see objects nearby clearly, while objects in the distance appear blurry. Evidence: TAS. Frequency: Very frequent (HP:0040281). (ORPHA:2069)
- Upslanted palpebral fissure (HP:0000582): The palpebral fissure inclination is more than two standard deviations above the mean for age (objective); or, the inclination of the palpebral fissure is greater than typical for age. Evidence: TAS. Frequency: Occasional (HP:0040283). (ORPHA:2069)
- Synophrys (HP:0000664): Meeting of the medial eyebrows in the midline. Evidence: TAS. Frequency: Occasional (HP:0040283). (ORPHA:2069)
- Melanocytic nevus (HP:0000995): A oval and round, colored (usually medium-to dark brown, reddish brown, or flesh colored) lesion. Typically, a melanocytic nevus is less than 6 mm in diameter, but may be much smaller or larger. Evidence: TAS. Frequency: Very frequent (HP:0040281). (ORPHA:2069)
- Multiple lentigines (HP:0001003): Presence of an unusually high number of lentigines (singular: lentigo), which are flat, tan to brown oval spots. Evidence: TAS. Frequency: Very frequent (HP:0040281). (ORPHA:2069)
- Coronary artery atherosclerosis (HP:0001677): Reduction of the diameter of the coronary arteries as the result of an accumulation of atheromatous plaques within the walls of the coronary arteries, which increases the risk of myocardial ischemia. Evidence: TAS. Frequency: Occasional (HP:0040283). (ORPHA:2069)
- Hiatus hernia (HP:0002036): The presence of a hernia in which the upper part of the stomach, i.e., mainly the gastric cardia protrudes through the diaphragmatic esophageal hiatus. Evidence: TAS. Frequency: Very frequent (HP:0040281). (ORPHA:2069)
- Peptic ulcer (HP:0004398): The term peptic ulcer refers to acid peptic injury of the digestive tract, resulting in mucosal break reaching the submucosa. Peptic ulcers are usually located in the stomach or proximal duodenum, but they can also be found in the esophagus or Meckel's diverticulum. Infection with Helicobacter pylori and the use of non steroidal antiinflammatory drugs (NSAIDs) or aspirin are the main risk factors of both gastric and duodenal peptic ulcers. Evidence: TAS. Frequency: Very frequent (HP:0040281). (ORPHA:2069)
- Depressed nasal bridge (HP:0005280): Posterior positioning of the nasal root in relation to the overall facial profile for age. Evidence: TAS. Frequency: Frequent (HP:0040282). (ORPHA:2069)
- Type II diabetes mellitus (HP:0005978): A type of diabetes mellitus initially characterized by insulin resistance and hyperinsulinemia and subsequently by glucose interolerance and hyperglycemia. Evidence: TAS. Frequency: Frequent (HP:0040282). (ORPHA:2069)
- Multiple cafe-au-lait spots (HP:0007565): The presence of six or more cafe-au-lait spots. Evidence: TAS. Frequency: Very frequent (HP:0040281). (ORPHA:2069)